- Myopia (HP:0000545): An abnormality of refraction characterized by the ability to see objects nearby clearly, while objects in the distance appear blurry. Evidence: TAS. (OMIM:609258)
This phenotype is associated with the disease myopia 9 (OMIM:609258).